Phenotypes associated with the disease Xq27.3q28 duplication syndrome (ORPHA:261483):
- Cryptorchidism (HP:0000028): Testis in inguinal canal. That is, absence of one or both testes from the scrotum owing to failure of the testis or testes to descend through the inguinal canal to the scrotum. Evidence: TAS. Frequency: Very frequent (HP:0040281). (ORPHA:261483)
- Hypogonadism (HP:0000135): A decreased functionality of the gonad. Evidence: TAS. Frequency: Very frequent (HP:0040281). (ORPHA:261483)
- Thin vermilion border (HP:0000233): Height of the vermilion of the medial part of the lip more than 2 SD below the mean, or apparently reduced height of the vermilion of the lip in the frontal view. The vermilion is the red part of the lips (and confusingly, the vermilion itself is also often referred to as being equivalent the lips). Evidence: TAS. Frequency: Very frequent (HP:0040281). (ORPHA:261483)
- Bulbous nose (HP:0000414): Increased volume and globular shape of the anteroinferior aspect of the nose. Evidence: TAS. Frequency: Very frequent (HP:0040281). (ORPHA:261483)
- Deeply set eye (HP:0000490): An eye that is more deeply recessed into the plane of the face than is typical. Evidence: TAS. Frequency: Very frequent (HP:0040281). (ORPHA:261483)
- Mild intellectual disability (HP:0001256): Mild intellectual disability (ID) is defined as a type of ID characterized by mildly sub-average adaptive functioning and intellectual functioning, with an intelligence quotient (IQ) the range of 50-69. Evidence: TAS. Frequency: Very frequent (HP:0040281). (ORPHA:261483)
- Global developmental delay (HP:0001263): A delay in the achievement of motor or mental milestones in the domains of development of a child, including motor skills, speech and language, cognitive skills, and social and emotional skills. This term should only be used to describe children younger than five years of age. Evidence: TAS. Frequency: Very frequent (HP:0040281). (ORPHA:261483)
- Failure to thrive (HP:0001508): Failure to thrive (FTT) refers to a child whose physical growth is substantially below the norm. Evidence: TAS. Frequency: Very frequent (HP:0040281). (ORPHA:261483)
- Abnormally high-pitched voice (HP:0001620): A persistent (minutes to hours) abnormal increase in the pitch (frequency) of the voice for the context or social situation or significantly different from baseline of the individual. Evidence: TAS. Frequency: Very frequent (HP:0040281). (ORPHA:261483)
- Short foot (HP:0001773): A measured foot length that is more than 2 SD below the mean for a newborn of 27 - 41 weeks gestation, or foot that is less than the 3rd centile for individuals from birth to 16 years of age (objective). Alternatively, a foot that appears disproportionately short (subjective). Evidence: TAS. Frequency: Very frequent (HP:0040281). (ORPHA:261483)
- Short stature (HP:0004322): A height below that which is expected according to age and gender norms. Although there is no universally accepted definition of short stature, many refer to "short stature" as height more than 2 standard deviations below the mean for age and gender (or below the 3rd percentile for age and gender dependent norms). Evidence: TAS. Frequency: Very frequent (HP:0040281). (ORPHA:261483)
- Decreased testicular size (HP:0008734): Reduced volume of the testicle (the male gonad). Evidence: TAS. Frequency: Very frequent (HP:0040281). (ORPHA:261483)
- Small hand (HP:0200055): Disproportionately small hand. Evidence: TAS. Frequency: Very frequent (HP:0040281). (ORPHA:261483)
- Gynecomastia (HP:0000771): Abnormal development of large mammary glands in males resulting in breast enlargement. Evidence: TAS. Frequency: Frequent (HP:0040282). (ORPHA:261483)
- Hypotonia (HP:0001252): Hypotonia is an abnormally low muscle tone (the amount of tension or resistance to movement in a muscle). Even when relaxed, muscles have a continuous and passive partial contraction which provides some resistance to passive stretching. Hypotonia thus manifests as diminished resistance to passive stretching. Hypotonia is not the same as muscle weakness, although the two conditions can co-exist. Evidence: TAS. Frequency: Frequent (HP:0040282). (ORPHA:261483)
- Intrauterine growth retardation (HP:0001511): An abnormal restriction of fetal growth with fetal weight below the tenth percentile for gestational age. Evidence: TAS. Frequency: Frequent (HP:0040282). (ORPHA:261483)
- Truncal obesity (HP:0001956): Obesity located preferentially in the trunk of the body as opposed to the extremities. Evidence: TAS. Frequency: Frequent (HP:0040282). (ORPHA:261483)
- Sparse body hair (HP:0002231): Sparseness of the body hair. Evidence: TAS. Frequency: Frequent (HP:0040282). (ORPHA:261483)
- Delayed skeletal maturation (HP:0002750): A decreased rate of skeletal maturation. Delayed skeletal maturation can be diagnosed on the basis of an estimation of the bone age from radiographs of specific bones in the human body. Evidence: TAS. Frequency: Frequent (HP:0040282). (ORPHA:261483)